Phenotypes associated with the disease Severe microbrachycephaly-intellectual disability-athetoid cerebral palsy syndrome (ORPHA:1236):
- Abnormal palate morphology (HP:0000174): Any abnormality of the palate, i.e., of roof of the mouth. Evidence: TAS. Frequency: Frequent (HP:0040282). (ORPHA:1236)
- Brachycephaly (HP:0000248): An abnormality of skull shape characterized by a decreased anterior-posterior diameter. That is, a cephalic index greater than 81%. Alternatively, an apparently shortened anteroposterior dimension (length) of the head compared to width. Evidence: TAS. Frequency: Very frequent (HP:0040281). (ORPHA:1236)
- Microcephaly (HP:0000252): Head circumference below 2 standard deviations below the mean for age and gender. Evidence: TAS. Frequency: Very frequent (HP:0040281). (ORPHA:1236)
- Mandibular prognathia (HP:0000303): Abnormal prominence of the chin related to increased length of the mandible. Evidence: TAS. Frequency: Frequent (HP:0040282). (ORPHA:1236)
- Hypertelorism (HP:0000316): Interpupillary distance more than 2 SD above the mean (alternatively, the appearance of an increased interpupillary distance or widely spaced eyes). Evidence: TAS. Frequency: Very frequent (HP:0040281). (ORPHA:1236)
- Facial asymmetry (HP:0000324): An abnormal difference between the left and right sides of the face. Evidence: TAS. Frequency: Frequent (HP:0040282). (ORPHA:1236)
- Broad forehead (HP:0000337): Width of the forehead or distance between the frontotemporales is more than two standard deviations above the mean (objective); or apparently increased distance between the two sides of the forehead. Evidence: TAS. Frequency: Very frequent (HP:0040281). (ORPHA:1236)
- Preauricular skin tag (HP:0000384): A rudimentary tag of skin often containing ear tissue including a core of cartilage and located just anterior to the auricle (outer part of the ear). Evidence: TAS. Frequency: Frequent (HP:0040282). (ORPHA:1236)
- Strabismus (HP:0000486): A misalignment of the eyes so that the visual axes deviate from bifoveal fixation. The classification of strabismus may be based on a number of features including the relative position of the eyes, whether the deviation is latent or manifest, intermittent or constant, concomitant or otherwise and according to the age of onset and the relevance of any associated refractive error. Evidence: TAS. Frequency: Frequent (HP:0040282). (ORPHA:1236)
- Telecanthus (HP:0000506): Distance between the inner canthi more than two standard deviations above the mean (objective); or, apparently increased distance between the inner canthi. Evidence: TAS. Frequency: Very frequent (HP:0040281). (ORPHA:1236)
- Microphthalmia (HP:0000568): A developmental anomaly characterized by abnormal smallness of one or both eyes. Evidence: TAS. Frequency: Frequent (HP:0040282). (ORPHA:1236)
- Blue sclerae (HP:0000592): An abnormal bluish coloration of the sclera. Evidence: TAS. Frequency: Frequent (HP:0040282). (ORPHA:1236)
- Iris coloboma (HP:0000612): A coloboma of the iris. Evidence: TAS. Frequency: Frequent (HP:0040282). (ORPHA:1236)
- Hypodontia (HP:0000668): The absence of five or less teeth from the normal series by a failure to develop. Evidence: TAS. Frequency: Very frequent (HP:0040281). (ORPHA:1236)
- Abnormal thorax morphology (HP:0000765): Any abnormality of the thorax (the region of the body formed by the sternum, the thoracic vertebrae and the ribs). Evidence: TAS. Frequency: Frequent (HP:0040282). (ORPHA:1236)
- Tapered finger (HP:0001182): The gradual reduction in girth of the finger from proximal to distal. Evidence: TAS. Frequency: Frequent (HP:0040282). (ORPHA:1236)
- Seizure (HP:0001250): A seizure is an intermittent abnormality of nervous system physiology characterized by a transient occurrence of signs and/or symptoms due to abnormal excessive or synchronous neuronal activity in the brain. Evidence: TAS. Frequency: Frequent (HP:0040282). (ORPHA:1236)
- Hypertonia (HP:0001276): A condition in which there is increased muscle tone so that arms or legs, for example, are stiff and difficult to move. Evidence: TAS. Frequency: Very frequent (HP:0040281). (ORPHA:1236)
- Tessier cleft (HP:0002006): A congenital malformation with a cleft (gap or opening) in the face. Evidence: TAS. Frequency: Very frequent (HP:0040281). (ORPHA:1236)
- Frontal bossing (HP:0002007): Bilateral bulging of the lateral frontal bone prominences with relative sparing of the midline. Evidence: TAS. Frequency: Very frequent (HP:0040281). (ORPHA:1236)
- Supernumerary nipple (HP:0002558): Presence of more than two nipples. Evidence: TAS. Frequency: Very frequent (HP:0040281). (ORPHA:1236)
- Scoliosis (HP:0002650): The presence of an abnormal lateral curvature of the spine. Evidence: TAS. Frequency: Very frequent (HP:0040281). (ORPHA:1236)
- Abnormal dermatoglyphics (HP:0007477): An abnormality of dermatoglyphs (fingerprints), which are present on fingers, palms, toes, and soles. Evidence: TAS. Frequency: Very frequent (HP:0040281). (ORPHA:1236)
- Bilateral single transverse palmar creases (HP:0007598): The distal and proximal transverse palmar creases are merged into a single transverse palmar crease on both hands. Evidence: TAS. Frequency: Very frequent (HP:0040281). (ORPHA:1236)
- Large earlobe (HP:0009748): Increased volume of the earlobe, that is, abnormally prominent ear lobules. Evidence: TAS. Frequency: Very frequent (HP:0040281). (ORPHA:1236)
- Dimple chin (HP:0010751): A persistent midline depression of the skin over the fat pad of the chin. Evidence: TAS. Frequency: Very frequent (HP:0040281). (ORPHA:1236)
- Broad thumb (HP:0011304): Increased thumb width without increased dorso-ventral dimension. Evidence: TAS. Frequency: Very frequent (HP:0040281). (ORPHA:1236)
- Abnormality of movement (HP:0100022): An abnormality of movement with a neurological basis characterized by changes in coordination and speed of voluntary movements. Evidence: TAS. Frequency: Very frequent (HP:0040281). (ORPHA:1236)
- Lip pit (HP:0100267): A depression located on a lip. Evidence: TAS. Frequency: Frequent (HP:0040282). (ORPHA:1236)
- Camptodactyly of finger (HP:0100490): The distal interphalangeal joint and/or the proximal interphalangeal joint of the fingers cannot be extended to 180 degrees by either active or passive extension. Evidence: TAS. Frequency: Frequent (HP:0040282). (ORPHA:1236)
- Cognitive impairment (HP:0100543): Abnormal cognition is characterized by deficits in thinking, reasoning, or remembering. Evidence: TAS. Frequency: Very frequent (HP:0040281). (ORPHA:1236)
- Hypoplasia of the ear cartilage (HP:0100720). Evidence: TAS. Frequency: Very frequent (HP:0040281). (ORPHA:1236)